- Female infertility (HP:0008222). Evidence: PCS. Frequency: 2/2. (PMID:34704130)
- Young adult onset (HP:0011462): Onset of disease at the age of between 16 and 40 years. Evidence: PCS. Frequency: 2/2. (PMID:34704130)
- Autosomal recessive inheritance (HP:0000007): A mode of inheritance that is observed for traits related to a gene encoded on one of the autosomes (i.e., the human chromosomes 1-22) in which a trait manifests in individuals with two pathogenic alleles, either homozygotes (two copies of the same mutant allele) or compound heterozygotes (whereby each copy of a gene has a distinct mutant allele). Evidence: PCS. (PMID:34704130)
These phenotypes are associated with the disease oocyte maturation defect 11 (OMIM:619643).